- Abnormality of metabolism/homeostasis (HP:0001939). Evidence: IEA. (OMIM:212790)
- Autosomal recessive inheritance (HP:0000007): A mode of inheritance that is observed for traits related to a gene encoded on one of the autosomes (i.e., the human chromosomes 1-22) in which a trait manifests in individuals with two pathogenic alleles, either homozygotes (two copies of the same mutant allele) or compound heterozygotes (whereby each copy of a gene has a distinct mutant allele). Evidence: IEA. (OMIM:212790)
- Sporadic (HP:0003745): Cases of the disease in question occur without a previous family history, i.e., as isolated cases without being transmitted from a parent and without other siblings being affected. Evidence: TAS. (OMIM:212790)
These phenotypes are associated with the disease premature centromere division (OMIM:212790).